Phenotypes associated with the disease Avian influenza (ORPHA:454836, an Orphanet rare-disease identifier):
- Fever (HP:0001945, a Human Phenotype Ontology term): Body temperature elevated above the normal range. Evidence: TAS. Frequency: Very frequent (HP:0040281, a Human Phenotype Ontology term). (ORPHA:454836)
- Myalgia (HP:0003326, a Human Phenotype Ontology term): Pain in muscle. Evidence: TAS. Frequency: Very frequent (HP:0040281, a Human Phenotype Ontology term). (ORPHA:454836)
- Fatigue (HP:0012378, a Human Phenotype Ontology term): A subjective feeling of tiredness characterized by a lack of energy and motivation. Evidence: TAS. Frequency: Very frequent (HP:0040281, a Human Phenotype Ontology term). (ORPHA:454836)
- Cough (HP:0012735, a Human Phenotype Ontology term): A sudden, audible expulsion of air from the lungs through a partially closed glottis, preceded by inhalation. Evidence: TAS. Frequency: Very frequent (HP:0040281, a Human Phenotype Ontology term). (ORPHA:454836)
- Pharyngitis (HP:0025439, a Human Phenotype Ontology term): Inflammation (due to infection or irritation) of the pharynx. Evidence: TAS. Frequency: Very frequent (HP:0040281, a Human Phenotype Ontology term). (ORPHA:454836)
- Thrombocytopenia (HP:0001873, a Human Phenotype Ontology term): A reduction in the number of circulating thrombocytes. Evidence: TAS. Frequency: Frequent (HP:0040282, a Human Phenotype Ontology term). (ORPHA:454836)
- Decreased total leukocyte count (HP:0001882, a Human Phenotype Ontology term): An abnormal decreased number of leukocytes in the blood. Evidence: TAS. Frequency: Frequent (HP:0040282, a Human Phenotype Ontology term). (ORPHA:454836)
- Decreased total lymphocyte count (HP:0001888, a Human Phenotype Ontology term): A reduced number of lymphocytes in the blood. Evidence: TAS. Frequency: Frequent (HP:0040282, a Human Phenotype Ontology term). (ORPHA:454836)
- Pulmonary infiltrates (HP:0002113, a Human Phenotype Ontology term). Evidence: TAS. Frequency: Frequent (HP:0040282, a Human Phenotype Ontology term). (ORPHA:454836)
- Headache (HP:0002315, a Human Phenotype Ontology term): Cephalgia, or pain sensed in various parts of the head, not confined to the area of distribution of any nerve. Evidence: TAS. Frequency: Frequent (HP:0040282, a Human Phenotype Ontology term). (ORPHA:454836)
- Elevated circulating C-reactive protein concentration (HP:0011227, a Human Phenotype Ontology term): The concentration of C-reactive protein in the blood circulation is above the upper limit of normal. Evidence: TAS. Frequency: Frequent (HP:0040282, a Human Phenotype Ontology term). (ORPHA:454836)
- Hypoxemia (HP:0012418, a Human Phenotype Ontology term): An abnormally low level of blood oxygen. Evidence: TAS. Frequency: Frequent (HP:0040282, a Human Phenotype Ontology term). (ORPHA:454836)
- Ground-glass opacification (HP:0025179, a Human Phenotype Ontology term): On chest radiographs, ground-glass opacity appears as an area of hazy increased lung opacity, usually extensive, within which margins of pulmonary vessels may be indistinct. On CT scans, it appears as hazy increased opacity of lung, with preservation of bronchial and vascular margins. It is caused by partial filling of airspaces, interstitial thickening (due to fluid, cells, and/or fibrosis), partial collapse of alveoli, increased capillary blood volume, or a combination of these, the common factor being the partial displacement of air. Ground-glass opacity is less opaque than consolidation, in which bronchovascular margins are obscured. Evidence: TAS. Frequency: Frequent (HP:0040282, a Human Phenotype Ontology term). (ORPHA:454836)
- Nonproductive cough (HP:0031246, a Human Phenotype Ontology term): A cough that does not produce phlegm or mucus. Evidence: TAS. Frequency: Frequent (HP:0040282, a Human Phenotype Ontology term). (ORPHA:454836)
- Conjunctivitis (HP:0000509, a Human Phenotype Ontology term): Inflammation of the conjunctiva. Evidence: TAS. Frequency: Occasional (HP:0040283, a Human Phenotype Ontology term). (ORPHA:454836)
- Vomiting (HP:0002013, a Human Phenotype Ontology term): Forceful ejection of the contents of the stomach through the mouth by means of a series of involuntary spasmic contractions. Evidence: TAS. Frequency: Occasional (HP:0040283, a Human Phenotype Ontology term). (ORPHA:454836)
- Diarrhea (HP:0002014, a Human Phenotype Ontology term): Abnormally increased frequency (usually defined as three or more) loose or watery bowel movements a day. Evidence: TAS. Frequency: Occasional (HP:0040283, a Human Phenotype Ontology term). (ORPHA:454836)
- Abdominal pain (HP:0002027, a Human Phenotype Ontology term): An unpleasant sensation characterized by physical discomfort (such as pricking, throbbing, or aching) and perceived to originate in the abdomen. Evidence: TAS. Frequency: Occasional (HP:0040283, a Human Phenotype Ontology term). (ORPHA:454836)
- Pneumonia (HP:0002090, a Human Phenotype Ontology term): Inflammation of any part of the lung parenchyma. Evidence: TAS. Frequency: Occasional (HP:0040283, a Human Phenotype Ontology term). (ORPHA:454836)
- Dyspnea (HP:0002094, a Human Phenotype Ontology term): Difficult or labored breathing. Dyspnea is a subjective feeling only the patient can rate, e.g., on a Borg scale. Evidence: TAS. Frequency: Occasional (HP:0040283, a Human Phenotype Ontology term). (ORPHA:454836)
- Pleural effusion (HP:0002202, a Human Phenotype Ontology term): The presence of an excessive amount of fluid in the pleural cavity. Evidence: TAS. Frequency: Occasional (HP:0040283, a Human Phenotype Ontology term). (ORPHA:454836)
- Respiratory failure (HP:0002878, a Human Phenotype Ontology term): A severe form of respiratory insufficiency characterized by inadequate gas exchange such that the levels of oxygen or carbon dioxide cannot be maintained within normal limits. Evidence: TAS. Frequency: Occasional (HP:0040283, a Human Phenotype Ontology term). (ORPHA:454836)
- Miscarriage (HP:0005268, a Human Phenotype Ontology term): A pregnancy that ends at a stage in which the fetus is incapable of surviving on its own, defined as the spontaneous loss of a fetus before the 22th week of pregnancy. Evidence: TAS. Frequency: Occasional (HP:0040283, a Human Phenotype Ontology term). (ORPHA:454836)
- Increased circulating lactate dehydrogenase concentration (HP:0025435, a Human Phenotype Ontology term): An elevated level of the enzyme lactate dehydrogenase in the blood circulation. Evidence: TAS. Frequency: Occasional (HP:0040283, a Human Phenotype Ontology term). (ORPHA:454836)
- Productive cough (HP:0031245, a Human Phenotype Ontology term): A cough that produces phlegm or mucus. Evidence: TAS. Frequency: Occasional (HP:0040283, a Human Phenotype Ontology term). (ORPHA:454836)
- Chest pain (HP:0100749, a Human Phenotype Ontology term): An unpleasant sensation characterized by physical discomfort (such as pricking, throbbing, or aching) localized to the chest. Evidence: TAS. Frequency: Occasional (HP:0040283, a Human Phenotype Ontology term). (ORPHA:454836)
- Meningitis (HP:0001287, a Human Phenotype Ontology term): Inflammation of the meninges. Evidence: TAS. Frequency: Very rare (HP:0040284, a Human Phenotype Ontology term). (ORPHA:454836)
- Congestive heart failure (HP:0001635, a Human Phenotype Ontology term): The presence of an abnormality of cardiac function that is responsible for the failure of the heart to pump blood at a rate that is commensurate with the needs of the tissues or a state in which abnormally elevated filling pressures are required for the heart to do so. Heart failure is frequently related to a defect in myocardial contraction. Evidence: TAS. Frequency: Very rare (HP:0040284, a Human Phenotype Ontology term). (ORPHA:454836)
- Acute kidney injury (HP:0001919, a Human Phenotype Ontology term): Sudden loss of renal function, as manifested by decreased urine production, and a rise in serum creatinine or blood urea nitrogen concentration (azotemia). Evidence: TAS. Frequency: Very rare (HP:0040284, a Human Phenotype Ontology term). (ORPHA:454836)
- Respiratory distress (HP:0002098, a Human Phenotype Ontology term): Respiratory distress is objectively observable as the physical or emotional consequences from the experience of dyspnea. The physical presentation of respiratory distress is generally referred to as labored breathing, while the sensation of respiratory distress is called shortness of breath or dyspnea. Evidence: TAS. Frequency: Very rare (HP:0040284, a Human Phenotype Ontology term). (ORPHA:454836)
- Pneumothorax (HP:0002107, a Human Phenotype Ontology term): Accumulation of air in the pleural cavity leading to a partially or completely collapsed lung. Evidence: TAS. Frequency: Very rare (HP:0040284, a Human Phenotype Ontology term). (ORPHA:454836)
- Infectious encephalitis (HP:0002383, a Human Phenotype Ontology term): A disorder of the brain caused by an infectious agent that presents with fever, headache, and an altered level of consciousness. There may also be focal or multifocal neurologic deficits, and focal or generalized seizure activity. Evidence: TAS. Frequency: Very rare (HP:0040284, a Human Phenotype Ontology term). (ORPHA:454836)
- Tachypnea (HP:0002789, a Human Phenotype Ontology term): Very rapid breathing. Evidence: TAS. Frequency: Very rare (HP:0040284, a Human Phenotype Ontology term). (ORPHA:454836)
- Elevated circulating hepatic transaminase concentration (HP:0002910, a Human Phenotype Ontology term): Elevations of the levels of SGOT and SGPT in the serum. SGOT (serum glutamic oxaloacetic transaminase) and SGPT (serum glutamic pyruvic transaminase) are transaminases primarily found in the liver and heart and are released into the bloodstream as the result of liver or heart damage. SGOT and SGPT are used clinically mainly as markers of liver damage. Evidence: TAS. Frequency: Very rare (HP:0040284, a Human Phenotype Ontology term). (ORPHA:454836)
- Hypoalbuminemia (HP:0003073, a Human Phenotype Ontology term): The concentration of albumin in the blood circulation is below the lower limit of normal. Evidence: TAS. Frequency: Very rare (HP:0040284, a Human Phenotype Ontology term). (ORPHA:454836)
- Rhabdomyolysis (HP:0003201, a Human Phenotype Ontology term): Breakdown of muscle fibers that leads to the release of muscle fiber contents (myoglobin) into the bloodstream. Evidence: TAS. Frequency: Very rare (HP:0040284, a Human Phenotype Ontology term). (ORPHA:454836)
- Elevated circulating creatine kinase activity (HP:0003236, a Human Phenotype Ontology term): The activity of creatine kinase in the blood circulation is above the upper limit of normal. Evidence: TAS. Frequency: Very rare (HP:0040284, a Human Phenotype Ontology term). (ORPHA:454836)
- Disseminated intravascular coagulation (HP:0005521, a Human Phenotype Ontology term): Disseminated intravascular coagulation is characterized by the widespread activation of coagulation, which results in the intravascular formation of fibrin and ultimately thrombotic occlusion of small and midsize vessels. Evidence: TAS. Frequency: Very rare (HP:0040284, a Human Phenotype Ontology term). (ORPHA:454836)
- Hepatitis (HP:0012115, a Human Phenotype Ontology term): Inflammation of the liver. Evidence: TAS. Frequency: Very rare (HP:0040284, a Human Phenotype Ontology term). (ORPHA:454836)
- Myelitis (HP:0012486, a Human Phenotype Ontology term): Inflammation of the spinal cord. Evidence: TAS. Frequency: Very rare (HP:0040284, a Human Phenotype Ontology term). (ORPHA:454836)
- Sepsis (HP:0100806, a Human Phenotype Ontology term): Sepsis is defined as life-threatening organ dysfunction caused by a dysregulated host response to infection. Evidence: TAS. Frequency: Very rare (HP:0040284, a Human Phenotype Ontology term). (ORPHA:454836)